- Stroke (HP:0001297): Sudden impairment of blood flow to a part of the brain due to occlusion or rupture of an artery to the brain. Evidence: TAS. Frequency: Very frequent (HP:0040281). (ORPHA:100008)
- Cerebral hemorrhage (HP:0001342): Hemorrhage into the parenchyma of the brain. Evidence: TAS. Frequency: Very frequent (HP:0040281). (ORPHA:100008)
- Amyloid deposition (HP:0011034): Pathologic deposits of specific fibrillar protein aggregates with distinct microscopic properties, particularly affinity for the dye Congo red with typical birefringence. Evidence: TAS. Frequency: Frequent (HP:0040282). (ORPHA:100008)
- Cerebral amyloid angiopathy (HP:0011970): Amyloid deposition in the walls of leptomeningeal and cortical arteries, arterioles, and less often capillaries and veins of the central nervous system. Evidence: TAS. Frequency: Very frequent (HP:0040281). (ORPHA:100008)
- Death in early adulthood (HP:0100613): Death between the age of 16 and 40 years. Evidence: TAS. Frequency: Occasional (HP:0040283). (ORPHA:100008)
These phenotypes are associated with the disease ACys amyloidosis (ORPHA:100008).